Phenotypes associated with the disease amelogenesis imperfecta type 1C (OMIM:204650):
- Amelogenesis imperfecta (HP:0000705): A developmental dysplasia of the dental enamel. Evidence: PCS. Frequency: 3/3. (PMID:14684688)
- Enamel hypomineralization (HP:0006285): A decreased amount of enamel mineralization. Hypomineralized enamel has a brown discoloration and brittle aspect. Evidence: PCS. Frequency: 3/3. (PMID:14684688)
- Anterior open-bite malocclusion (HP:0009102): Anterior open bite is a malocclusion characterized by a gap between the anterior teeth (incisors), that is, by a deficiency in the normal vertical overlap between antagonist incisal edges when the posterior teeth are in occlusion. Evidence: PCS. (PMID:14684688)
- Yellow-brown discoloration of the teeth (HP:0006286). Evidence: PCS. (PMID:14684688)
- Taurodontia (HP:0000679): Increased volume of dental pulp of permanent molar characterized by a crown body-root ratio equal or larger than 1:1 or an elongated pulp chambers and apical displacement of the bifurcation or trifurcation of the roots. Evidence: PCS. Frequency: 0/3. (PMID:14684688)
- Autosomal recessive inheritance (HP:0000007): A mode of inheritance that is observed for traits related to a gene encoded on one of the autosomes (i.e., the human chromosomes 1-22) in which a trait manifests in individuals with two pathogenic alleles, either homozygotes (two copies of the same mutant allele) or compound heterozygotes (whereby each copy of a gene has a distinct mutant allele). Evidence: PCS. (PMID:14684688)